- Hypertension (HP:0000822): The presence of chronic increased pressure in the systemic arterial system. Evidence: TAS. Frequency: Occasional (HP:0040283). (ORPHA:139411)
- Ascites (HP:0001541): Accumulation of fluid in the peritoneal cavity (between the layers of the peritoneum that lines the abdomen). Evidence: TAS. Frequency: Frequent (HP:0040282). (ORPHA:139411)
- Tachycardia (HP:0001649): A rapid heartrate that exceeds the range of the normal resting heartrate for age. Evidence: TAS. Frequency: Frequent (HP:0040282). (ORPHA:139411)
- Anemia (HP:0001903): A reduction in erythrocytes volume or hemoglobin concentration. Evidence: TAS. Frequency: Occasional (HP:0040283). (ORPHA:139411)
- Diarrhea (HP:0002014): Abnormally increased frequency (usually defined as three or more) loose or watery bowel movements a day. Evidence: TAS. Frequency: Very frequent (HP:0040281). (ORPHA:139411)
- Nausea and vomiting (HP:0002017): Nausea is a commonly encountered symptom that has been defined as an unpleasant painless subjective feeling that one will imminently vomit. Vomiting has been defined as the forceful expulsion of the contents of the stomach, duodenum, or jejunum through the oral cavity. While nausea and vomiting are often thought to exist on a temporal continuum, this is not always the case. There are situations when severe nausea may be present without emesis and less frequently, when emesis may be present without preceding nausea. Evidence: TAS. Frequency: Very frequent (HP:0040281). (ORPHA:139411)
- Abdominal pain (HP:0002027): An unpleasant sensation characterized by physical discomfort (such as pricking, throbbing, or aching) and perceived to originate in the abdomen. Evidence: TAS. Frequency: Very frequent (HP:0040281). (ORPHA:139411)
- Anorexia (HP:0002039): Lack of desire to eat (loss of appetite). Evidence: TAS. Frequency: Occasional (HP:0040283). (ORPHA:139411)
- Pulmonary infiltrates (HP:0002113). Evidence: TAS. Frequency: Frequent (HP:0040282). (ORPHA:139411)
- Gastrointestinal hemorrhage (HP:0002239): Hemorrhage affecting the gastrointestinal tract. Evidence: TAS. Frequency: Very frequent (HP:0040281). (ORPHA:139411)
- Headache (HP:0002315): Cephalgia, or pain sensed in various parts of the head, not confined to the area of distribution of any nerve. Evidence: TAS. Frequency: Occasional (HP:0040283). (ORPHA:139411)
- Pheochromocytoma (HP:0002666): Pheochromocytomas (also known as chromaffin tumors) produce, store, and secrete catecholamines. Pheochromocytomas usually originate from the adrenal medulla but may also develop from chromaffin cells in or about sympathetic ganglia. A common symptom of pheochromocytoma is hypertension owing to release of catecholamines. Evidence: TAS. Frequency: Very frequent (HP:0040281). (ORPHA:139411)
- Paraganglioma (HP:0002668): A carotid body tumor (also called paraganglionoma or chemodectoma) is a tumor found in the upper neck at the branching of the carotid artery. They arise from the chemoreceptor organ (paraganglion) located in the adventitia of the carotid artery bifurcation. Evidence: TAS. Frequency: Frequent (HP:0040282). (ORPHA:139411)
- Lymphadenopathy (HP:0002716): Enlargement (swelling) of a lymph node. Evidence: TAS. Frequency: Occasional (HP:0040283). (ORPHA:139411)
- Adrenal overactivity (HP:0002717). Evidence: TAS. Frequency: Frequent (HP:0040282). (ORPHA:139411)
- Adrenocortical adenoma (HP:0008256): Adrenocortical adenomas are benign tumors of the adrenal cortex. Evidence: TAS. Frequency: Frequent (HP:0040282). (ORPHA:139411)
- Arrhythmia (HP:0011675): Any cardiac rhythm other than the normal sinus rhythm. Such a rhythm may be either of sinus or ectopic origin and either regular or irregular. An arrhythmia may be due to a disturbance in impulse formation or conduction or both. Evidence: TAS. Frequency: Occasional (HP:0040283). (ORPHA:139411)
- Fatigue (HP:0012378): A subjective feeling of tiredness characterized by a lack of energy and motivation. Evidence: TAS. Frequency: Very frequent (HP:0040281). (ORPHA:139411)
- Leiomyosarcoma (HP:0100243): A smooth muscle connective tissue tumor, which is rare type of cancer that is a malignant neoplasm of smooth muscle. When such a neoplasm is benign, it is called a leiomyoma. Evidence: TAS. Frequency: Very frequent (HP:0040281). (ORPHA:139411)
- Mediastinal lymphadenopathy (HP:0100721): Swelling of lymph nodes within the mediastinum, the central compartment of the thoracic cavities that contains the heart and the great vessels, the esophagus, and trachea and other structures including lymph nodes. Evidence: TAS. Frequency: Frequent (HP:0040282). (ORPHA:139411)
- Gastrointestinal stroma tumor (HP:0100723). Evidence: TAS. Frequency: Very frequent (HP:0040281). (ORPHA:139411)
These phenotypes are associated with the disease Carney triad (ORPHA:139411).